Phenotypes associated with the disease brachydactyly-nystagmus-cerebellar ataxia syndrome (OMIM:113400):
- Strabismus (HP:0000486): A misalignment of the eyes so that the visual axes deviate from bifoveal fixation. The classification of strabismus may be based on a number of features including the relative position of the eyes, whether the deviation is latent or manifest, intermittent or constant, concomitant or otherwise and according to the age of onset and the relevance of any associated refractive error. Evidence: IEA. (OMIM:113400)
- Brachydactyly (HP:0001156): Digits that appear disproportionately short compared to the hand/foot. The word brachydactyly is used here to describe a series distinct patterns of shortened digits (brachydactyly types A-E). This is the sense used here. Evidence: TAS. (OMIM:113400)
- Nystagmus (HP:0000639): Rhythmic, involuntary oscillations of one or both eyes related to abnormality in fixation, conjugate gaze, or vestibular mechanisms. Evidence: IEA. (OMIM:113400)
- Ataxia (HP:0001251): Ataxia refers to impaired coordination of voluntary muscle movement. Cerebellar ataxia refers to ataxia due to dysfunction of the cerebellum. This causes a variety of elementary neurological deficits including asynergy (lack of coordination between muscles, limbs and joints), dysmetria (lack of ability to judge distances that can lead to under- or overshoot in grasping movements), and dysdiadochokinesia (inability to perform rapid movements requiring antagonizing muscle groups to be switched on and off repeatedly). Evidence: IEA. (OMIM:113400)
- Short metacarpal (HP:0010049): Diminished length of one or more metacarpal bones in relation to the others of the same hand or to the contralateral metacarpal. Evidence: TAS. (OMIM:113400)
- Intellectual disability (HP:0001249): The term intellectual disability or intellectual developmental disorder is used to describe significantly sub-average intellectual and adaptive functioning based on clinical assessment and as measured by individually administered, appropriately normed, standardized and validated tests of intellectual functioning and adaptive behavior, with onset during the developmental period from infancy through adolescence. Evidence: IEA. (OMIM:113400)
- Autosomal dominant inheritance (HP:0000006): A mode of inheritance that is observed for traits related to a gene encoded on one of the autosomes (i.e., the human chromosomes 1-22) in which a trait manifests in heterozygotes. In the context of medical genetics, an autosomal dominant disorder is caused when a single copy of the mutant allele is present. Males and females are affected equally, and can both transmit the disorder with a risk of 50% for each child of inheriting the mutant allele. Evidence: TAS. (OMIM:113400)
- Short metatarsal (HP:0010743): Diminished length of a metatarsal bone, with resultant proximal displacement of the associated toe. Evidence: TAS. (OMIM:113400)